Phenotypes associated with the disease Microtriplication 11q24.1 syndrome (ORPHA:289522):
- Coarse facial features (HP:0000280): Absence of fine and sharp appearance of brows, nose, lips, mouth, and chin, usually because of rounded and heavy features or thickened skin with or without thickening of subcutaneous and bony tissues. Evidence: TAS. Frequency: Very frequent (HP:0040281). (ORPHA:289522)
- Hypertelorism (HP:0000316): Interpupillary distance more than 2 SD above the mean (alternatively, the appearance of an increased interpupillary distance or widely spaced eyes). Evidence: TAS. Frequency: Very frequent (HP:0040281). (ORPHA:289522)
- Smooth philtrum (HP:0000319): Flat skin surface, with no ridge formation in the central region of the upper lip between the nasal base and upper vermilion border. Evidence: TAS. Frequency: Very frequent (HP:0040281). (ORPHA:289522)
- Short philtrum (HP:0000322): Distance between nasal base and midline upper lip vermilion border more than 2 SD below the mean. Alternatively, an apparently decreased distance between nasal base and midline upper lip vermilion border. Evidence: TAS. Frequency: Very frequent (HP:0040281). (ORPHA:289522)
- Posteriorly rotated ears (HP:0000358): A type of abnormal location of the ears in which the position of the ears is characterized by posterior rotation (the superior part of the ears is rotated towards the back of the head, and the inferior part of the ears towards the front). Evidence: TAS. Frequency: Very frequent (HP:0040281). (ORPHA:289522)
- Wide nose (HP:0000445): Interalar distance more than two standard deviations above the mean for age, i.e., an apparently increased width of the nasal base and alae. Evidence: TAS. Frequency: Very frequent (HP:0040281). (ORPHA:289522)
- Long eyelashes (HP:0000527): Mid upper eyelash length >10 mm or increased length of the eyelashes (subjective). Evidence: TAS. Frequency: Very frequent (HP:0040281). (ORPHA:289522)
- Keratoconus (HP:0000563): A cone-shaped deformity of the cornea characterized by the presence of corneal distortion secondary to thinning of the apex. Evidence: TAS. Frequency: Very frequent (HP:0040281). (ORPHA:289522)
- Thick eyebrow (HP:0000574): Increased density/number and/or increased diameter of eyebrow hairs. Evidence: TAS. Frequency: Very frequent (HP:0040281). (ORPHA:289522)
- Upslanted palpebral fissure (HP:0000582): The palpebral fissure inclination is more than two standard deviations above the mean for age (objective); or, the inclination of the palpebral fissure is greater than typical for age. Evidence: TAS. Frequency: Very frequent (HP:0040281). (ORPHA:289522)
- Synophrys (HP:0000664): Meeting of the medial eyebrows in the midline. Evidence: TAS. Frequency: Very frequent (HP:0040281). (ORPHA:289522)
- Delayed speech and language development (HP:0000750): A degree of language development that is significantly below the norm for a child of a specified age. Evidence: TAS. Frequency: Very frequent (HP:0040281). (ORPHA:289522)
- Intellectual disability (HP:0001249): The term intellectual disability or intellectual developmental disorder is used to describe significantly sub-average intellectual and adaptive functioning based on clinical assessment and as measured by individually administered, appropriately normed, standardized and validated tests of intellectual functioning and adaptive behavior, with onset during the developmental period from infancy through adolescence. Evidence: TAS. Frequency: Very frequent (HP:0040281). (ORPHA:289522)
- Joint dislocation (HP:0001373): Displacement or malalignment of joints. Evidence: TAS. Frequency: Very frequent (HP:0040281). (ORPHA:289522)
- Limitation of joint mobility (HP:0001376): A reduction in the freedom of movement of one or more joints. Evidence: TAS. Frequency: Very frequent (HP:0040281). (ORPHA:289522)
- Obesity (HP:0001513): Accumulation of substantial excess body fat. Evidence: TAS. Frequency: Very frequent (HP:0040281). (ORPHA:289522)
- Talipes equinovarus (HP:0001762): Talipes equinovarus (also called clubfoot) typically has four main components: inversion and adduction of the forefoot; inversion of the heel and hindfoot; equinus (limitation of extension) of the ankle and subtalar joint; and internal rotation of the leg. Evidence: TAS. Frequency: Very frequent (HP:0040281). (ORPHA:289522)
- Short foot (HP:0001773): A measured foot length that is more than 2 SD below the mean for a newborn of 27 - 41 weeks gestation, or foot that is less than the 3rd centile for individuals from birth to 16 years of age (objective). Alternatively, a foot that appears disproportionately short (subjective). Evidence: TAS. Frequency: Very frequent (HP:0040281). (ORPHA:289522)
- Metatarsus adductus (HP:0001840): The metatarsals are deviated medially (tibially), that is, the bones in the front half of the foot bend or turn in toward the body. Evidence: TAS. Frequency: Very frequent (HP:0040281). (ORPHA:289522)
- Abnormal facial shape (HP:0001999): An abnormal morphology (form) of the face or its components. Evidence: TAS. Frequency: Very frequent (HP:0040281). (ORPHA:289522)
- Hyperkinetic movements (HP:0002487): Motor hyperactivity with excessive movement of muscles of the body as a whole. Evidence: TAS. Frequency: Very frequent (HP:0040281). (ORPHA:289522)
- Genu valgum (HP:0002857): The legs angle inward, such that the knees are close together and the ankles far apart. Evidence: TAS. Frequency: Very frequent (HP:0040281). (ORPHA:289522)
- Hyperlipidemia (HP:0003077): An elevated lipid concentration in the blood. Evidence: TAS. Frequency: Very frequent (HP:0040281). (ORPHA:289522)
- Bruxism (HP:0003763): Bruxism is characterized by the grinding of the teeth including the clenching of the jaw and typically occur during sleep. Evidence: TAS. Frequency: Very frequent (HP:0040281). (ORPHA:289522)
- Clinodactyly of the 5th finger (HP:0004209): Clinodactyly refers to a bending or curvature of the fifth finger in the radial direction (i.e., towards the 4th finger). Evidence: TAS. Frequency: Very frequent (HP:0040281). (ORPHA:289522)
- Short stature (HP:0004322): A height below that which is expected according to age and gender norms. Although there is no universally accepted definition of short stature, many refer to "short stature" as height more than 2 standard deviations below the mean for age and gender (or below the 3rd percentile for age and gender dependent norms). Evidence: TAS. Frequency: Very frequent (HP:0040281). (ORPHA:289522)
- Irregularly spaced teeth (HP:0006316): Irregular distribution of the teeth along the dental arch, i.e., and irregular spatial pattern of teeth. Evidence: TAS. Frequency: Very frequent (HP:0040281). (ORPHA:289522)
- Attached earlobe (HP:0009907): Attachment of the lobe to the side of the face at the lowest point of the lobe without curving upward. Evidence: TAS. Frequency: Very frequent (HP:0040281). (ORPHA:289522)
- Speech apraxia (HP:0011098): A type of apraxia that is characterized by difficulty or inability to execute speech movements because of problems with coordination and motor problems, leading to incorrect articulation. An increase of errors with increasing word and phrase length may occur. Evidence: TAS. Frequency: Very frequent (HP:0040281). (ORPHA:289522)
- Broad chin (HP:0011822): Increased width of the midpoint of the mandible (mental protuberance) and overlying soft tissue. Evidence: TAS. Frequency: Very frequent (HP:0040281). (ORPHA:289522)
- Small hand (HP:0200055): Disproportionately small hand. Evidence: TAS. Frequency: Very frequent (HP:0040281). (ORPHA:289522)
- Cleft palate (HP:0000175): Cleft palate is a developmental defect of the palate resulting from a failure of fusion of the palatine processes and manifesting as a separation of the roof of the mouth (soft and hard palate). Evidence: TAS. Frequency: Frequent (HP:0040282). (ORPHA:289522)
- Microcephaly (HP:0000252): Head circumference below 2 standard deviations below the mean for age and gender. Evidence: TAS. Frequency: Frequent (HP:0040282). (ORPHA:289522)
- Hearing impairment (HP:0000365): A decreased magnitude of the sensory perception of sound. Evidence: TAS. Frequency: Frequent (HP:0040282). (ORPHA:289522)
- Short neck (HP:0000470): Diminished length of the neck. Evidence: TAS. Frequency: Frequent (HP:0040282). (ORPHA:289522)
- Generalized hypotonia (HP:0001290): Generalized muscular hypotonia (abnormally low muscle tone). Evidence: TAS. Frequency: Frequent (HP:0040282). (ORPHA:289522)
- Scoliosis (HP:0002650): The presence of an abnormal lateral curvature of the spine. Evidence: TAS. Frequency: Frequent (HP:0040282). (ORPHA:289522)
- Retrocerebellar cyst (HP:0006951). Evidence: TAS. Frequency: Frequent (HP:0040282). (ORPHA:289522)
Not associated with this disease:
- Seizure (HP:0001250): A seizure is an intermittent abnormality of nervous system physiology characterized by a transient occurrence of signs and/or symptoms due to abnormal excessive or synchronous neuronal activity in the brain. Evidence: TAS. (ORPHA:289522)